- Craniosynostosis (HP:0001363): Craniosynostosis refers to the premature closure of the cranial sutures. Primary craniosynostosis refers to the closure of one or more sutures due to abnormalities in skull development, and secondary craniosynostosis results from failure of brain growth. Evidence: TAS. (OMIM:617439)
- Delayed speech and language development (HP:0000750): A degree of language development that is significantly below the norm for a child of a specified age. Evidence: TAS. (OMIM:617439)
- Neurodevelopmental delay (HP:0012758): Neurodevelopmental delay (NDD) refers to delays in the maturation of the brain and central nervous system; infants and young children with NDD may experience delays in the development of one or more skills including gross motor abilities, fine-motor coordination, language abilities and ability to solve increasingly complex problems. Evidence: TAS. (OMIM:617439)
- Autosomal dominant inheritance (HP:0000006): A mode of inheritance that is observed for traits related to a gene encoded on one of the autosomes (i.e., the human chromosomes 1-22) in which a trait manifests in heterozygotes. In the context of medical genetics, an autosomal dominant disorder is caused when a single copy of the mutant allele is present. Males and females are affected equally, and can both transmit the disorder with a risk of 50% for each child of inheriting the mutant allele. Evidence: TAS. (OMIM:617439)
These phenotypes are associated with the disease craniosynostosis 7 (OMIM:617439).